Phenotypes associated with the disease Cystic echinococcosis (ORPHA:400):
- Hepatic cysts (HP:0001407). Evidence: TAS. Frequency: Very frequent (HP:0040281). (ORPHA:400)
- Increased total eosinophil count (HP:0001880): Increased count of eosinophils in the blood. Evidence: TAS. Frequency: Very frequent (HP:0040281). (ORPHA:400)
- Weight loss (HP:0001824): Reduction of total body weight. Evidence: TAS. Frequency: Frequent (HP:0040282). (ORPHA:400)
- Cholestatic liver disease (HP:0002611). Evidence: TAS. Frequency: Frequent (HP:0040282). (ORPHA:400)
- Increased circulating immunoglobulin concentration (HP:0010702): An increased level of gamma globulin (immunoglobulin) in the blood. Evidence: TAS. Frequency: Frequent (HP:0040282). (ORPHA:400)
- Fatigue (HP:0012378): A subjective feeling of tiredness characterized by a lack of energy and motivation. Evidence: TAS. Frequency: Frequent (HP:0040282). (ORPHA:400)
- Epigastric pain (HP:0410019): Pain that is localized to the region of the upper abdomen immediately below the ribs. Evidence: TAS. Frequency: Frequent (HP:0040282). (ORPHA:400)
- Abnormality of the diaphragm (HP:0000775): Any abnormality of the diaphragm, the sheet of skeletal muscle that separates the thoracic cavity from the abdominal cavity. Evidence: TAS. Frequency: Occasional (HP:0040283). (ORPHA:400)
- Hepatomegaly (HP:0002240): Abnormally increased size of the liver. Evidence: TAS. Frequency: Occasional (HP:0040283). (ORPHA:400)
- Hyperbilirubinemia (HP:0002904): An increased amount of bilirubin in the blood. Evidence: TAS. Frequency: Occasional (HP:0040283). (ORPHA:400)
- Elevated circulating hepatic transaminase concentration (HP:0002910): Elevations of the levels of SGOT and SGPT in the serum. SGOT (serum glutamic oxaloacetic transaminase) and SGPT (serum glutamic pyruvic transaminase) are transaminases primarily found in the liver and heart and are released into the bloodstream as the result of liver or heart damage. SGOT and SGPT are used clinically mainly as markers of liver damage. Evidence: TAS. Frequency: Occasional (HP:0040283). (ORPHA:400)
- Elevated circulating alkaline phosphatase concentration (HP:0003155): Abnormally increased serum levels of alkaline phosphatase activity. Evidence: TAS. Frequency: Occasional (HP:0040283). (ORPHA:400)
- Biliary tract obstruction (HP:0005230): Obstruction affecting the biliary tree. Evidence: TAS. Frequency: Occasional (HP:0040283). (ORPHA:400)
- Multiple pulmonary cysts (HP:0005948): The presence of multiple lung cysts. Evidence: TAS. Frequency: Occasional (HP:0040283). (ORPHA:400)
- Abdominal symptom (HP:0011458): A subjective manifestation of disease localized to the abdomen. Evidence: TAS. Frequency: Occasional (HP:0040283). (ORPHA:400)
- Abscess (HP:0025615): An abscess is a localized collection of purulent material surrounded by inflammation and granulation. Evidence: TAS. Frequency: Occasional (HP:0040283). (ORPHA:400)
- Elevated gamma-glutamyltransferase level (HP:0030948): Increased level of the enzyme gamma-glutamyltransferase (GGT). GGT is mainly present in kidney, liver, and pancreatic cells, but small amounts are present in other tissues. Evidence: TAS. Frequency: Occasional (HP:0040283). (ORPHA:400)
- Abnormal pulmonary thoracic imaging finding (HP:0031983): This term groups terms representing abnormal findings derived from chest X-ray investigation of the lung. In general, lung abnormalities can manifest as opacities (areas of increased density) or as regions with decreased density. Evidence: TAS. Frequency: Occasional (HP:0040283). (ORPHA:400)
- Unusual infection (HP:0032101): Increased susceptibility to infection, as manifested by recurrent infection, severe or invasive infection, infection occurring in an unusual anatomical location, or infection with opportunistic organisms, that is unusual for a healthy individual of the same age. Evidence: TAS. Frequency: Occasional (HP:0040283). (ORPHA:400)
- Pulmonary cyst (HP:0032445): A round circumscribed space within a lung that is surrounded by an epithelial or fibrous wall of variable thickness. A cyst usually has a thin and regular wall (less than 2 mm) and contains air, although some may contain fluid. Evidence: TAS. Frequency: Occasional (HP:0040283). (ORPHA:400)
- Anaphylactic shock (HP:0100845): An acute hypersensitivity reaction due to exposure to a previously encountered antigen. Evidence: TAS. Frequency: Occasional (HP:0040283). (ORPHA:400)
- Renal cyst (HP:0000107): A fluid filled sac in the kidney. Evidence: TAS. Frequency: Very rare (HP:0040284). (ORPHA:400)
- Ovarian cyst (HP:0000138): The presence of one or more cysts of the ovary. Evidence: TAS. Frequency: Very rare (HP:0040284). (ORPHA:400)
- Abnormality of the eye (HP:0000478): Any abnormality of the eye, including location, spacing, and intraocular abnormalities. Evidence: TAS. Frequency: Very rare (HP:0040284). (ORPHA:400)
- Abnormality of the vertebral column (HP:0000925): Any abnormality of the vertebral column. Evidence: TAS. Frequency: Very rare (HP:0040284). (ORPHA:400)
- Jaundice (HP:0000952): Yellow pigmentation of the skin due to bilirubin, which in turn is the result of increased bilirubin concentration in the bloodstream. Evidence: TAS. Frequency: Very rare (HP:0040284). (ORPHA:400)
- Urticaria (HP:0001025): Raised, well-circumscribed areas of erythema and edema involving the dermis and epidermis. Urticaria is intensely pruritic, and blanches completely with pressure. Evidence: TAS. Frequency: Very rare (HP:0040284). (ORPHA:400)
- Abnormal heart morphology (HP:0001627): Any structural anomaly of the heart. Evidence: TAS. Frequency: Very rare (HP:0040284). (ORPHA:400)
- Abnormality of the pancreas (HP:0001732): An abnormality of the pancreas. Evidence: TAS. Frequency: Very rare (HP:0040284). (ORPHA:400)
- Asthma (HP:0002099): Asthma is characterized by increased responsiveness of the tracheobronchial tree to multiple stimuli, leading to narrowing of the air passages with resultant dyspnea, cough, and wheezing. Evidence: TAS. Frequency: Very rare (HP:0040284). (ORPHA:400)
- Abnormal peritoneum morphology (HP:0002585): An abnormality of the peritoneum. Evidence: TAS. Frequency: Very rare (HP:0040284). (ORPHA:400)
- Abnormality of the musculature (HP:0003011): Abnormality originating in one or more muscles, i.e., of the set of muscles of body. Evidence: TAS. Frequency: Very rare (HP:0040284). (ORPHA:400)
- Intracranial cystic lesion (HP:0010576): A cystic lesion originating within the brain. Evidence: TAS. Frequency: Very rare (HP:0040284). (ORPHA:400)
- Localized skin lesion (HP:0011355): A lesion of the skin that is located in a specific region rather than being generalized. Evidence: TAS. Frequency: Very rare (HP:0040284). (ORPHA:400)
- Bone cyst (HP:0012062): A fluid filled cavity that develops with a bone. Evidence: TAS. Frequency: Very rare (HP:0040284). (ORPHA:400)
- Membranous nephropathy (HP:0012578): A type of glomerulonephropathy characterized by thickening of the basement membrane and deposition of immune complexes in the subepithelial space. Evidence: TAS. Frequency: Very rare (HP:0040284). (ORPHA:400)
- Splenic cyst (HP:0030423): A closed sac located in the spleen. Evidence: TAS. Frequency: Very rare (HP:0040284). (ORPHA:400)
- Abnormal subpleural morphology (HP:0031630): Any structural anomaly located between the pleura and the chest wall. Evidence: TAS. Frequency: Very rare (HP:0040284). (ORPHA:400)
- Invasive parasitic infection (HP:0031700): A parasitic infection whereby the parasite invades (migrates through) tissues of the infected host. Evidence: TAS. Frequency: Very rare (HP:0040284). (ORPHA:400)
- Abnormality of the testis size (HP:0045058): An anomaly of the size of the testicle (the male gonad). Evidence: TAS. Frequency: Very rare (HP:0040284). (ORPHA:400)
- Peritoneal abscess (HP:0100592): The presence of an abscess of the peritoneum. Evidence: TAS. Frequency: Very rare (HP:0040284). (ORPHA:400)